- Resting tremor (HP:0002322): A resting tremor occurs when muscles are at rest and becomes less noticeable or disappears when the affected muscles are moved. Resting tremors are often slow and coarse. Evidence: PCS. Frequency: 6/8. (PMID:33141179)
- Middle age onset (HP:0003596): A type of adult onset with onset of symptoms at the age of 40 to 60 years. Evidence: PCS. Frequency: 4/8. (PMID:33141179)
- Bradykinesia (HP:0002067): Bradykinesia literally means slow movement, and is used clinically to denote a slowness in the execution of movement (in contrast to hypokinesia, which is used to refer to slowness in the initiation of movement). Evidence: PCS. Frequency: 8/8. (PMID:33141179)
- Decreased motor nerve conduction velocity (HP:0003431): A type of decreased nerve conduction velocity that affects the motor neuron. Evidence: PCS. Frequency: 4/5. (PMID:33141179)
- Late onset (HP:0003584): A type of adult onset with onset of symptoms after the age of 60 years. Evidence: PCS. Frequency: 4/8. (PMID:33141179)
- Polyneuropathy (HP:0001271): A generalized disorder of peripheral nerves. Evidence: PCS. Frequency: 4/5. (PMID:33141179)
- Rigidity (HP:0002063): Continuous involuntary sustained muscle contraction. When an affected muscle is passively stretched, the degree of resistance remains constant regardless of the rate at which the muscle is stretched. This feature helps to distinguish rigidity from muscle spasticity. Evidence: PCS. Frequency: 8/8. (PMID:33141179)
- Decreased compound muscle action potential amplitude (HP:0033383): Reduced level of the compound muscle action potential (CMAP), which is recorded following electrical stimulation of a nerve from surface electrodes overlying a muscle supplied by that nerve. Evidence: PCS. Frequency: 5/5. (PMID:33141179)
- Depression (HP:0000716): Frequently experiencing feelings of being down, miserable, and/or hopeless; struggling to recover from these moods; having a pessimistic outlook on the future; feeling a pervasive sense of shame; having a low self-worth; experiencing thoughts of suicide and engaging in suicidal behavior. Evidence: PCS. Frequency: 2/5. (PMID:33141179)
- Anxiety (HP:0000739): Intense feelings of nervousness, tension, or panic often arise in response to interpersonal stresses. There is worry about the negative effects of past unpleasant experiences and future negative possibilities. Individuals may feel fearful, apprehensive, or threatened by uncertainty, and they may also have fears of falling apart or losing control. Evidence: PCS. Frequency: 5/5. (PMID:33141179)
- Decreased amplitude of sensory action potentials (HP:0007078): A reduction in the amplitude of sensory nerve action potential. This feature is measured by nerve conduction studies. Evidence: PCS. Frequency: 5/5. (PMID:33141179)
- Diffuse cerebral atrophy (HP:0002506): Diffuse unlocalised atrophy affecting the cerebrum. Evidence: PCS. Frequency: 3/5. (PMID:33141179)
- Parkinsonism with favorable response to dopaminergic medication (HP:0002548): Parkinsonism is a clinical syndrome that is a feature of a number of different diseases, including Parkinson disease itself, other neurodegenerative diseases such as progressive supranuclear palsy, and as a side-effect of some neuroleptic medications. Some but not all individuals with Parkinsonism show responsiveness to dopaminergic medication defined as a substantial reduction of amelioration of the component signs of Parkinsonism (including mainly tremor, bradykinesia, rigidity, and postural instability) upon administration of dopaminergic medication. Evidence: PCS. Frequency: 8/8. (PMID:33141179)
- Autosomal dominant inheritance (HP:0000006): A mode of inheritance that is observed for traits related to a gene encoded on one of the autosomes (i.e., the human chromosomes 1-22) in which a trait manifests in heterozygotes. In the context of medical genetics, an autosomal dominant disorder is caused when a single copy of the mutant allele is present. Males and females are affected equally, and can both transmit the disorder with a risk of 50% for each child of inheriting the mutant allele. Evidence: PCS. (PMID:33141179)
These phenotypes are associated with the disease parkinsonism with polyneuropathy (OMIM:619279).